- Sex-limited expression (HP:0001470): Sex limitation is used to refer to a monogenic trait linked to an autosomal locus in which the phenotypic effects of allelic differences are expressed only in one sex. Evidence: IEA. (OMIM:113670)
- Abnormal thorax morphology (HP:0000765): Any abnormality of the thorax (the region of the body formed by the sternum, the thoracic vertebrae and the ribs). Evidence: IEA. (OMIM:113670)
These phenotypes are associated with the disease familial juvenile hypertrophy of the breast (OMIM:113670).